- Bilateral tonic-clonic seizure (HP:0002069): A bilateral tonic-clonic seizure is a seizure defined by a tonic (bilateral increased tone, lasting seconds to minutes) and then a clonic (bilateral sustained rhythmic jerking) phase. Evidence: PCS. Frequency: 5/6. (PMID:33085104)
- Juvenile onset (HP:0003621): Onset of signs or symptoms of disease between the age of 5 and 15 years. Evidence: PCS. Frequency: 4/6. (PMID:33085104)
- Dysmetria (HP:0001310): A type of ataxia characterized by the inability to carry out movements with the correct range and motion across the plane of more than one joint related to incorrect estimation of the distances required for targeted movements. Evidence: PCS. Frequency: 3/6. (PMID:33085104)
- Gait disturbance (HP:0001288): The term gait disturbance can refer to any disruption of the ability to walk. Evidence: PCS. Frequency: 6/6. (PMID:33085104)
- Dysarthria (HP:0001260): Dysarthric speech is a general description referring to a neurological speech disorder characterized by poor articulation. Depending on the involved neurological structures, dysarthria may be further classified as spastic, flaccid, ataxic, hyperkinetic and hypokinetic, or mixed. Evidence: PCS. Frequency: 4/6. (PMID:33085104)
- Ataxia (HP:0001251): Ataxia refers to impaired coordination of voluntary muscle movement. Cerebellar ataxia refers to ataxia due to dysfunction of the cerebellum. This causes a variety of elementary neurological deficits including asynergy (lack of coordination between muscles, limbs and joints), dysmetria (lack of ability to judge distances that can lead to under- or overshoot in grasping movements), and dysdiadochokinesia (inability to perform rapid movements requiring antagonizing muscle groups to be switched on and off repeatedly). Evidence: PCS. Frequency: 6/6. (PMID:33085104)
- Depression (HP:0000716): Frequently experiencing feelings of being down, miserable, and/or hopeless; struggling to recover from these moods; having a pessimistic outlook on the future; feeling a pervasive sense of shame; having a low self-worth; experiencing thoughts of suicide and engaging in suicidal behavior. Evidence: PCS. Frequency: 2/6. (PMID:33085104)
- Young adult onset (HP:0011462): Onset of disease at the age of between 16 and 40 years. Evidence: PCS. Frequency: 2/6. (PMID:33085104)
- Anxiety (HP:0000739): Intense feelings of nervousness, tension, or panic often arise in response to interpersonal stresses. There is worry about the negative effects of past unpleasant experiences and future negative possibilities. Individuals may feel fearful, apprehensive, or threatened by uncertainty, and they may also have fears of falling apart or losing control. Evidence: PCS. Frequency: 1/6. (PMID:33085104)
- Autosomal recessive inheritance (HP:0000007): A mode of inheritance that is observed for traits related to a gene encoded on one of the autosomes (i.e., the human chromosomes 1-22) in which a trait manifests in individuals with two pathogenic alleles, either homozygotes (two copies of the same mutant allele) or compound heterozygotes (whereby each copy of a gene has a distinct mutant allele). Evidence: PCS. (PMID:33085104)
- Mental deterioration (HP:0001268): Loss of previously present mental abilities, generally in adults. Evidence: PCS. Frequency: 3/6. (PMID:33085104)
- Attention deficit hyperactivity disorder (HP:0007018): Attention deficit hyperactivity disorder (ADHD) manifests at age 2-3 years or by first grade at the latest. The main symptoms are distractibility, impulsivity, hyperactivity, and often trouble organizing tasks and projects, difficulty going to sleep, and social problems from being aggressive, loud, or impatient. Evidence: PCS. Frequency: 1/6. (PMID:33085104)
- Myoclonus (HP:0001336): Very brief, involuntary random muscular contractions occurring at rest, in response to sensory stimuli, or accompanying voluntary movements. Evidence: PCS. Frequency: 6/6. (PMID:33085104)
These phenotypes are associated with the disease epilepsy, progressive myoclonic, 12 (OMIM:619191).